- Hemangioma (HP:0001028): A hemangioma is a benign tumor characterized by blood-filled spaces lined by benign endothelial cells. A hemangioma characterized by large endothelial spaces (caverns) is called a cavernous hemangioma (in contrast to a hemangioma with small endothelial spaces, which is called capillary hemangioma). Evidence: TAS. Frequency: Obligate (HP:0040280). (ORPHA:464318)
- Inflammatory abnormality of the skin (HP:0011123): The presence of inflammation of the skin. That is, an abnormality of the skin resulting from the local accumulation of fluid, plasma proteins, and leukocytes. Evidence: TAS. Frequency: Frequent (HP:0040282). (ORPHA:464318)
- Regional abnormality of skin (HP:0011356): An abnormality of the skin that is restricted to a particular body region. Evidence: TAS. Frequency: Frequent (HP:0040282). (ORPHA:464318)
- Papilloma (HP:0012740): A tumor of the skin or mucous membrane with finger-like projections. Evidence: TAS. Frequency: Frequent (HP:0040282). (ORPHA:464318)
- Epidermal acanthosis (HP:0025092): Diffuse hypertrophy or thickening of the stratum spinosum of the epidermis (prickle cell layer of the skin). Evidence: TAS. Frequency: Frequent (HP:0040282). (ORPHA:464318)
- Hyperkeratotic papule (HP:0045059): A circumscribed, solid elevation of skin with no visible fluid, varying in size from a pinhead to less than 10mm in diameter at the widest point that is composed of localized hyperkeratosis (the latter may be demonstrated histopathologically). Evidence: TAS. Frequency: Frequent (HP:0040282). (ORPHA:464318)
- Skin plaque (HP:0200035): A plaque is a solid, raised, plateau-like (flat-topped) lesion greater than 1 cm in diameter. Evidence: TAS. Frequency: Frequent (HP:0040282). (ORPHA:464318)
These phenotypes are associated with the disease Verrucous hemangioma (ORPHA:464318).